Phenotypes associated with the disease 48,XXXY syndrome (ORPHA:96263):
- Joint hypermobility (HP:0001382): The capability that a joint (or a group of joints) has to move, passively and/or actively, beyond normal limits along physiological axes. Evidence: TAS. Frequency: Frequent (HP:0040282). (ORPHA:96263)
- Aggressive behavior (HP:0000718): Behavior or an act aimed at harming a person, animal, or physical property (e.g., acts of physical violence; shouting, swearing, and using harsh language; slashing someone's tires). Evidence: TAS. Frequency: Occasional (HP:0040283). (ORPHA:96263)
- Azoospermia (HP:0000027): Absence of any measurable level of sperm,whereby spermatozoa cannot be observed even after centrifugation of the semen pellet. Evidence: TAS. Frequency: Very frequent (HP:0040281). (ORPHA:96263)
- Hypogonadism (HP:0000135): A decreased functionality of the gonad. Evidence: TAS. Frequency: Very frequent (HP:0040281). (ORPHA:96263)
- Infertility (HP:0000789). Evidence: TAS. Frequency: Very frequent (HP:0040281). (ORPHA:96263)
- Mild intellectual disability (HP:0001256): Mild intellectual disability (ID) is defined as a type of ID characterized by mildly sub-average adaptive functioning and intellectual functioning, with an intelligence quotient (IQ) the range of 50-69. Evidence: TAS. Frequency: Very frequent (HP:0040281). (ORPHA:96263)
- Global developmental delay (HP:0001263): A delay in the achievement of motor or mental milestones in the domains of development of a child, including motor skills, speech and language, cognitive skills, and social and emotional skills. This term should only be used to describe children younger than five years of age. Evidence: TAS. Frequency: Very frequent (HP:0040281). (ORPHA:96263)
- Language impairment (HP:0002463): Language impairment is a deficit in comprehension or production of language that includes reduced vocabulary, limited sentence structure, or impairments in written or spoken communication. Language abilities are substantially and quantifiably below age expectations. Evidence: TAS. Frequency: Very frequent (HP:0040281). (ORPHA:96263)
- Decreased testicular size (HP:0008734): Reduced volume of the testicle (the male gonad). Evidence: TAS. Frequency: Very frequent (HP:0040281). (ORPHA:96263)
- Cryptorchidism (HP:0000028): Testis in inguinal canal. That is, absence of one or both testes from the scrotum owing to failure of the testis or testes to descend through the inguinal canal to the scrotum. Evidence: TAS. Frequency: Frequent (HP:0040282). (ORPHA:96263)
- Small scrotum (HP:0000046): Apparently small scrotum for age. Evidence: TAS. Frequency: Frequent (HP:0040282). (ORPHA:96263)
- Tall stature (HP:0000098): A height above that which is expected according to age and gender norms. Evidence: TAS. Frequency: Frequent (HP:0040282). (ORPHA:96263)
- Epicanthus (HP:0000286): A fold of skin starting above the medial aspect of the upper eyelid and arching downward to cover, pass in front of and lateral to the medial canthus. Evidence: TAS. Frequency: Frequent (HP:0040282). (ORPHA:96263)
- Hypertelorism (HP:0000316): Interpupillary distance more than 2 SD above the mean (alternatively, the appearance of an increased interpupillary distance or widely spaced eyes). Evidence: TAS. Frequency: Frequent (HP:0040282). (ORPHA:96263)
- Chronic otitis media (HP:0000389): Chronic otitis media refers to fluid, swelling, or infection of the middle ear that does not heal and may cause permanent damage to the ear. Evidence: TAS. Frequency: Frequent (HP:0040282). (ORPHA:96263)
- Depressed nasal ridge (HP:0000457): Lack of prominence of the nose resulting from a posteriorly-placed nasal ridge. Evidence: TAS. Frequency: Frequent (HP:0040282). (ORPHA:96263)
- Strabismus (HP:0000486): A misalignment of the eyes so that the visual axes deviate from bifoveal fixation. The classification of strabismus may be based on a number of features including the relative position of the eyes, whether the deviation is latent or manifest, intermittent or constant, concomitant or otherwise and according to the age of onset and the relevance of any associated refractive error. Evidence: TAS. Frequency: Frequent (HP:0040282). (ORPHA:96263)
- Upslanted palpebral fissure (HP:0000582): The palpebral fissure inclination is more than two standard deviations above the mean for age (objective); or, the inclination of the palpebral fissure is greater than typical for age. Evidence: TAS. Frequency: Frequent (HP:0040282). (ORPHA:96263)
- Carious teeth (HP:0000670): Caries is a multifactorial bacterial infection affecting the structure of the tooth. This term has been used to describe the presence of more than expected dental caries. Evidence: TAS. Frequency: Frequent (HP:0040282). (ORPHA:96263)
- Taurodontia (HP:0000679): Increased volume of dental pulp of permanent molar characterized by a crown body-root ratio equal or larger than 1:1 or an elongated pulp chambers and apical displacement of the bifurcation or trifurcation of the roots. Evidence: TAS. Frequency: Frequent (HP:0040282). (ORPHA:96263)
- Abnormal dental enamel morphology (HP:0000682): An abnormality of the dental enamel. Evidence: TAS. Frequency: Frequent (HP:0040282). (ORPHA:96263)
- Delayed eruption of teeth (HP:0000684): Delayed tooth eruption, which can be defined as tooth eruption more than 2 SD beyond the mean eruption age. Evidence: TAS. Frequency: Frequent (HP:0040282). (ORPHA:96263)
- Autism (HP:0000717): Autism is a neurodevelopmental disorder characterized by impaired social interaction and communication, and by restricted and repetitive behavior. Autism begins in childhood. It is marked by the presence of markedly abnormal or impaired development in social interaction and communication and a markedly restricted repertoire of activity and interest. Manifestations of the disorder vary greatly depending on the developmental level and chronological age of the individual (DSM-IV). Evidence: TAS. Frequency: Frequent (HP:0040282). (ORPHA:96263)
- Gynecomastia (HP:0000771): Abnormal development of large mammary glands in males resulting in breast enlargement. Evidence: TAS. Frequency: Frequent (HP:0040282). (ORPHA:96263)
- Hypotonia (HP:0001252): Hypotonia is an abnormally low muscle tone (the amount of tension or resistance to movement in a muscle). Even when relaxed, muscles have a continuous and passive partial contraction which provides some resistance to passive stretching. Hypotonia thus manifests as diminished resistance to passive stretching. Hypotonia is not the same as muscle weakness, although the two conditions can co-exist. Evidence: TAS. Frequency: Frequent (HP:0040282). (ORPHA:96263)
- Pes planus (HP:0001763): A foot where the longitudinal arch of the foot is in contact with the ground or floor when the individual is standing; or, in a patient lying supine, a foot where the arch is in contact with the surface of a flat board pressed against the sole of the foot by the examiner with a pressure similar to that expected from weight bearing; or, the height of the arch is reduced. Evidence: TAS. Frequency: Frequent (HP:0040282). (ORPHA:96263)
- Constipation (HP:0002019): Infrequent or difficult evacuation of feces. Evidence: TAS. Frequency: Frequent (HP:0040282). (ORPHA:96263)
- Asthma (HP:0002099): Asthma is characterized by increased responsiveness of the tracheobronchial tree to multiple stimuli, leading to narrowing of the air passages with resultant dyspnea, cough, and wheezing. Evidence: TAS. Frequency: Frequent (HP:0040282). (ORPHA:96263)
- Recurrent respiratory infections (HP:0002205): An increased susceptibility to respiratory infections as manifested by a history of recurrent respiratory infections. Evidence: TAS. Frequency: Frequent (HP:0040282). (ORPHA:96263)
- Radioulnar synostosis (HP:0002974): An abnormal osseous union (fusion) between the radius and the ulna. Evidence: TAS. Frequency: Frequent (HP:0040282). (ORPHA:96263)
- Elbow dislocation (HP:0003042): Dislocation of the distal humerus out of the elbow joint, where the radius, ulna, and humerus meet. Evidence: TAS. Frequency: Frequent (HP:0040282). (ORPHA:96263)
- Clinodactyly of the 5th finger (HP:0004209): Clinodactyly refers to a bending or curvature of the fifth finger in the radial direction (i.e., towards the 4th finger). Evidence: TAS. Frequency: Frequent (HP:0040282). (ORPHA:96263)
- Abnormal epiphysis morphology (HP:0005930): An anomaly of epiphysis, which is the expanded articular end of a long bone that developes from a secondary ossification center, and which during the period of growth is either entirely cartilaginous or is separated from the shaft by a cartilaginous disk. Evidence: TAS. Frequency: Frequent (HP:0040282). (ORPHA:96263)
- Attention deficit hyperactivity disorder (HP:0007018): Attention deficit hyperactivity disorder (ADHD) manifests at age 2-3 years or by first grade at the latest. The main symptoms are distractibility, impulsivity, hyperactivity, and often trouble organizing tasks and projects, difficulty going to sleep, and social problems from being aggressive, loud, or impatient. Evidence: TAS. Frequency: Frequent (HP:0040282). (ORPHA:96263)
- Hypoplasia of penis (HP:0008736). Evidence: TAS. Frequency: Frequent (HP:0040282). (ORPHA:96263)
- Open bite (HP:0010807): Visible space between the dental arches in occlusion. Evidence: TAS. Frequency: Frequent (HP:0040282). (ORPHA:96263)
- Down-sloping shoulders (HP:0200021): Low set, steeply sloping shoulders. Evidence: TAS. Frequency: Frequent (HP:0040282). (ORPHA:96263)
- Inguinal hernia (HP:0000023): Protrusion of the contents of the abdominal cavity through the inguinal canal. Evidence: TAS. Frequency: Occasional (HP:0040283). (ORPHA:96263)
- Renal dysplasia (HP:0000110): The presence of developmental dysplasia of the kidney. Evidence: TAS. Frequency: Occasional (HP:0040283). (ORPHA:96263)
- Cleft palate (HP:0000175): Cleft palate is a developmental defect of the palate resulting from a failure of fusion of the palatine processes and manifesting as a separation of the roof of the mouth (soft and hard palate). Evidence: TAS. Frequency: Occasional (HP:0040283). (ORPHA:96263)
- Brachycephaly (HP:0000248): An abnormality of skull shape characterized by a decreased anterior-posterior diameter. That is, a cephalic index greater than 81%. Alternatively, an apparently shortened anteroposterior dimension (length) of the head compared to width. Evidence: TAS. Frequency: Occasional (HP:0040283). (ORPHA:96263)
- Mandibular prognathia (HP:0000303): Abnormal prominence of the chin related to increased length of the mandible. Evidence: TAS. Frequency: Occasional (HP:0040283). (ORPHA:96263)
- Facial asymmetry (HP:0000324): An abnormal difference between the left and right sides of the face. Evidence: TAS. Frequency: Occasional (HP:0040283). (ORPHA:96263)
- Short neck (HP:0000470): Diminished length of the neck. Evidence: TAS. Frequency: Occasional (HP:0040283). (ORPHA:96263)
- Blepharophimosis (HP:0000581): A fixed reduction in the vertical distance between the upper and lower eyelids with short palpebral fissures. Evidence: TAS. Frequency: Occasional (HP:0040283). (ORPHA:96263)
- Irritability (HP:0000737): An emotional state characterized by negative feelings of heightened frustration, annoyance, or feeling upset, often triggered by internal factors (e.g., fatigue, hunger, unfulfilled desires) or external factors (e.g., social or environmental challenges). Irritability may be unpredictable, and is accompanied by a lowered threshold for emotional reactivity and observable features (speech, facial expressions, or psychomotor activity). Evidence: TAS. Frequency: Occasional (HP:0040283). (ORPHA:96263)
- Anxiety (HP:0000739): Intense feelings of nervousness, tension, or panic often arise in response to interpersonal stresses. There is worry about the negative effects of past unpleasant experiences and future negative possibilities. Individuals may feel fearful, apprehensive, or threatened by uncertainty, and they may also have fears of falling apart or losing control. Evidence: TAS. Frequency: Occasional (HP:0040283). (ORPHA:96263)
- Delayed speech and language development (HP:0000750): A degree of language development that is significantly below the norm for a child of a specified age. Evidence: TAS. Frequency: Occasional (HP:0040283). (ORPHA:96263)
- Seizure (HP:0001250): A seizure is an intermittent abnormality of nervous system physiology characterized by a transient occurrence of signs and/or symptoms due to abnormal excessive or synchronous neuronal activity in the brain. Evidence: TAS. Frequency: Occasional (HP:0040283). (ORPHA:96263)
- Tremor (HP:0001337): An unintentional, oscillating to-and-fro muscle movement about a joint axis. Evidence: TAS. Frequency: Occasional (HP:0040283). (ORPHA:96263)
- Obesity (HP:0001513): Accumulation of substantial excess body fat. Evidence: TAS. Frequency: Occasional (HP:0040283). (ORPHA:96263)
- Talipes equinovarus (HP:0001762): Talipes equinovarus (also called clubfoot) typically has four main components: inversion and adduction of the forefoot; inversion of the heel and hindfoot; equinus (limitation of extension) of the ankle and subtalar joint; and internal rotation of the leg. Evidence: TAS. Frequency: Occasional (HP:0040283). (ORPHA:96263)
- Gastroesophageal reflux (HP:0002020): A condition in which the stomach contents leak backwards from the stomach into the esophagus through the lower esophageal sphincter. Evidence: TAS. Frequency: Occasional (HP:0040283). (ORPHA:96263)
- Pulmonary embolism (HP:0002204): An embolus (that is, an abnormal particle circulating in the blood) located in the pulmonary artery and thereby blocking blood circulation to the lung. Usually the embolus is a blood clot that has developed in an extremity (for instance, a deep venous thrombosis), detached, and traveled through the circulation before becoming trapped in the pulmonary artery. Evidence: TAS. Frequency: Occasional (HP:0040283). (ORPHA:96263)
- Scoliosis (HP:0002650): The presence of an abnormal lateral curvature of the spine. Evidence: TAS. Frequency: Occasional (HP:0040283). (ORPHA:96263)
- Coxa valga (HP:0002673): Coxa valga is a deformity of the hip in which the angle between the femoral shaft and the femoral neck is increased compared to age-adjusted values (about 150 degrees in newborns gradually reducing to 120-130 degrees in adults). Evidence: TAS. Frequency: Occasional (HP:0040283). (ORPHA:96263)
- Hip dislocation (HP:0002827): Displacement of the femur from its normal location in the hip joint. Evidence: TAS. Frequency: Occasional (HP:0040283). (ORPHA:96263)
- Venous thrombosis (HP:0004936): Formation of a blood clot (thrombus) inside a vein, causing the obstruction of blood flow. Evidence: TAS. Frequency: Occasional (HP:0040283). (ORPHA:96263)
- Type II diabetes mellitus (HP:0005978): A type of diabetes mellitus initially characterized by insulin resistance and hyperinsulinemia and subsequently by glucose interolerance and hyperglycemia. Evidence: TAS. Frequency: Occasional (HP:0040283). (ORPHA:96263)
- Abnormal social behavior (HP:0012433): An abnormality of actions or reactions of a person exhibited during social interactions with other individuals. Evidence: TAS. Frequency: Occasional (HP:0040283). (ORPHA:96263)
- Abnormal cardiovascular system morphology (HP:0030680): Any structural anomaly of the heart and blood vessels. Evidence: TAS. Frequency: Occasional (HP:0040283). (ORPHA:96263)
- Schizophrenia (HP:0100753): A mental disorder characterized by a disintegration of thought processes and emotional responsiveness. It most commonly manifests as auditory hallucinations, paranoid or bizarre delusions, or disorganized speech and thinking. It is accompanied by significant social or occupational dysfunction. The onset of symptoms typically occurs in young adulthood, with a global lifetime prevalence of about 1%. This term is not a helpful parent term to describe abnormal experiences. Evidence: TAS. Frequency: Occasional (HP:0040283). (ORPHA:96263)